- Congenital onset (HP:0003577): A phenotypic abnormality that is present at birth. Evidence: PCS. Frequency: 8/8. (PMID:14570705)
- Sensorineural hearing impairment (HP:0000407): A type of hearing impairment in one or both ears related to an abnormal functionality of the cochlear nerve. Evidence: PCS. Frequency: 8/8. (PMID:14570705)
- Autosomal recessive inheritance (HP:0000007): A mode of inheritance that is observed for traits related to a gene encoded on one of the autosomes (i.e., the human chromosomes 1-22) in which a trait manifests in individuals with two pathogenic alleles, either homozygotes (two copies of the same mutant allele) or compound heterozygotes (whereby each copy of a gene has a distinct mutant allele). Evidence: PCS. (PMID:14570705)
- Visual impairment (HP:0000505): Visual impairment (or vision impairment) is vision loss (of a person) to such a degree as to qualify as an additional support need through a significant limitation of visual capability resulting from either disease, trauma, or congenital or degenerative conditions that cannot be corrected by conventional means, such as refractive correction, medication, or surgery. Evidence: PCS. Frequency: 0/8. (PMID:14570705)
These phenotypes are associated with the disease autosomal recessive nonsyndromic hearing loss 23 (OMIM:609533).